Phenotypes associated with the disease craniosynostosis-fibular aplasia syndrome (OMIM:218550):
- Craniosynostosis (HP:0001363): Craniosynostosis refers to the premature closure of the cranial sutures. Primary craniosynostosis refers to the closure of one or more sutures due to abnormalities in skull development, and secondary craniosynostosis results from failure of brain growth. Evidence: PCS. Frequency: 2/2. (PMID:8100584)
- Fibular aplasia (HP:0002990): Absence of the fibula. Evidence: PCS. Frequency: 2/2. (PMID:8100584)
- Single transverse palmar crease (HP:0000954): The distal and proximal transverse palmar creases are merged into a single transverse palmar crease. Evidence: PCS. Frequency: 2/2. (PMID:8100584)
- Autosomal recessive inheritance (HP:0000007): A mode of inheritance that is observed for traits related to a gene encoded on one of the autosomes (i.e., the human chromosomes 1-22) in which a trait manifests in individuals with two pathogenic alleles, either homozygotes (two copies of the same mutant allele) or compound heterozygotes (whereby each copy of a gene has a distinct mutant allele). Evidence: PCS. (PMID:8100584)
- Cryptorchidism (HP:0000028): Testis in inguinal canal. That is, absence of one or both testes from the scrotum owing to failure of the testis or testes to descend through the inguinal canal to the scrotum. Evidence: PCS. Frequency: 2/2. (PMID:8100584)